Phenotypes associated with the disease GOMBO syndrome (OMIM:233270, an entry in Online Mendelian Inheritance in Man):
- Microcephaly (HP:0000252, a Human Phenotype Ontology term): Head circumference below 2 standard deviations below the mean for age and gender. Evidence: IEA. (OMIM:233270)
- Brachydactyly (HP:0001156, a Human Phenotype Ontology term): Digits that appear disproportionately short compared to the hand/foot. The word brachydactyly is used here to describe a series distinct patterns of shortened digits (brachydactyly types A-E). This is the sense used here. Evidence: IEA. (OMIM:233270)
- Autosomal recessive inheritance (HP:0000007, a Human Phenotype Ontology term): A mode of inheritance that is observed for traits related to a gene encoded on one of the autosomes (i.e., the human chromosomes 1-22) in which a trait manifests in individuals with two pathogenic alleles, either homozygotes (two copies of the same mutant allele) or compound heterozygotes (whereby each copy of a gene has a distinct mutant allele). Evidence: IEA. (OMIM:233270)
- Microphthalmia (HP:0000568, a Human Phenotype Ontology term): A developmental anomaly characterized by abnormal smallness of one or both eyes. Evidence: IEA. (OMIM:233270)
- Abnormal cardiovascular system morphology (HP:0030680, a Human Phenotype Ontology term): Any structural anomaly of the heart and blood vessels. Evidence: IEA. (OMIM:233270)
- Radial deviation of finger (HP:0009466, a Human Phenotype Ontology term): Bending or curvature of a finger toward the radial side (i.e., towards the thumb). The deviation is at the metacarpal-phalangeal joint, and this finding is distinct from clinodactyly. Evidence: IEA. (OMIM:233270)
- Abnormal heart morphology (HP:0001627, a Human Phenotype Ontology term): Any structural anomaly of the heart. Evidence: TAS. (OMIM:233270)
- Delayed puberty (HP:0000823, a Human Phenotype Ontology term): Passing the age when puberty normally occurs with no physical or hormonal signs of the onset of puberty. Evidence: IEA. (OMIM:233270)
- Clinodactyly (HP:0030084, a Human Phenotype Ontology term): An angulation of a digit at an interphalangeal joint in the plane of the palm (finger) or sole (toe). Evidence: TAS. (OMIM:233270)
- Intellectual disability (HP:0001249, a Human Phenotype Ontology term): The term intellectual disability or intellectual developmental disorder is used to describe significantly sub-average intellectual and adaptive functioning based on clinical assessment and as measured by individually administered, appropriately normed, standardized and validated tests of intellectual functioning and adaptive behavior, with onset during the developmental period from infancy through adolescence. Evidence: IEA. (OMIM:233270)
- Severe intellectual disability (HP:0010864, a Human Phenotype Ontology term): Severe intellectual disability (ID) is defined as a type of ID characterized by severely sub-average adaptive functioning and intellectual functioning, with an intelligence quotient (IQ) the range of 20-34. Evidence: TAS. (OMIM:233270)